Phenotypes associated with the disease globulin anomaly involving beta (2A)-globulin (OMIM:137900):
- Abnormality of the coagulation cascade (HP:0003256): An abnormality of the coagulation cascade, which is comprised of the contact activation pathway (also known as the intrinsic pathway) and the tissue factor pathway (also known as the extrinsic pathway) as well as cofactors and regulators. Evidence: TAS. (OMIM:137900)
- Abnormality of the immune system (HP:0002715): An abnormality of the immune system. Evidence: IEA. (OMIM:137900)
- Autosomal dominant inheritance (HP:0000006): A mode of inheritance that is observed for traits related to a gene encoded on one of the autosomes (i.e., the human chromosomes 1-22) in which a trait manifests in heterozygotes. In the context of medical genetics, an autosomal dominant disorder is caused when a single copy of the mutant allele is present. Males and females are affected equally, and can both transmit the disorder with a risk of 50% for each child of inheriting the mutant allele. Evidence: IEA. (OMIM:137900)